Phenotypes associated with the disease Ménétrier disease (ORPHA:2494):
- Abnormal gastric mucosa morphology (HP:0004295): An abnormality of the gastric mucous membrane. Evidence: TAS. Frequency: Very frequent (HP:0040281). (ORPHA:2494)
- Giant hypertrophic gastritis (HP:0005246): A type of gastritis characterized by excessive proliferation of the gastric mucosa and diffuse thickening of the gastric mucosal folds. Evidence: TAS. Frequency: Very frequent (HP:0040281). (ORPHA:2494)
- Weight loss (HP:0001824): Reduction of total body weight. Evidence: TAS. Frequency: Frequent (HP:0040282). (ORPHA:2494)
- Vomiting (HP:0002013): Forceful ejection of the contents of the stomach through the mouth by means of a series of involuntary spasmic contractions. Evidence: TAS. Frequency: Frequent (HP:0040282). (ORPHA:2494)
- Nausea (HP:0002018): A sensation of unease in the stomach together with an urge to vomit. Evidence: TAS. Frequency: Frequent (HP:0040282). (ORPHA:2494)
- Abdominal pain (HP:0002027): An unpleasant sensation characterized by physical discomfort (such as pricking, throbbing, or aching) and perceived to originate in the abdomen. Evidence: TAS. Frequency: Frequent (HP:0040282). (ORPHA:2494)
- Hypoalbuminemia (HP:0003073): The concentration of albumin in the blood circulation is below the lower limit of normal. Evidence: TAS. Frequency: Frequent (HP:0040282). (ORPHA:2494)
- Hypoproteinemia (HP:0003075): A decreased concentration of protein in the blood. Evidence: TAS. Frequency: Frequent (HP:0040282). (ORPHA:2494)
- Malnutrition (HP:0004395): A deficiency in the intake of energy and nutrients. Evidence: TAS. Frequency: Frequent (HP:0040282). (ORPHA:2494)
- Helicobacter pylori infection (HP:0005202): A recurrent infection of the GI tract with helicobacter pylori, a gram-negative, microaerophilic bacterium usually found in the stomach. Evidence: TAS. Frequency: Frequent (HP:0040282). (ORPHA:2494)
- Peripheral edema (HP:0012398): An abnormal accumulation of interstitial fluid in the soft tissues of the limbs. Evidence: TAS. Frequency: Frequent (HP:0040282). (ORPHA:2494)
- Asthenia (HP:0025406): A state characterized by a feeling of weakness and loss of strength leading to a generalized weakness of the body. Evidence: TAS. Frequency: Frequent (HP:0040282). (ORPHA:2494)
- Diarrhea (HP:0002014): Abnormally increased frequency (usually defined as three or more) loose or watery bowel movements a day. Evidence: TAS. Frequency: Occasional (HP:0040283). (ORPHA:2494)
- Gastroesophageal reflux (HP:0002020): A condition in which the stomach contents leak backwards from the stomach into the esophagus through the lower esophageal sphincter. Evidence: TAS. Frequency: Occasional (HP:0040283). (ORPHA:2494)
- Anorexia (HP:0002039): Lack of desire to eat (loss of appetite). Evidence: TAS. Frequency: Occasional (HP:0040283). (ORPHA:2494)
- Gastrointestinal hemorrhage (HP:0002239): Hemorrhage affecting the gastrointestinal tract. Evidence: TAS. Frequency: Occasional (HP:0040283). (ORPHA:2494)
- Multiple gastric polyps (HP:0004394). Evidence: TAS. Frequency: Occasional (HP:0040283). (ORPHA:2494)
- Poor appetite (HP:0004396): A reduced desire to eat. Evidence: TAS. Frequency: Occasional (HP:0040283). (ORPHA:2494)
- Hypochromic microcytic anemia (HP:0004840): A type of anemia characterized by an abnormally low concentration of hemoglobin in the erythrocytes and lower than normal size of the erythrocytes. Evidence: TAS. Frequency: Occasional (HP:0040283). (ORPHA:2494)
- Stomach cancer (HP:0012126): A cancer arising in any part of the stomach. Evidence: TAS. Frequency: Occasional (HP:0040283). (ORPHA:2494)
- Thromboembolism (HP:0001907): The formation of a blood clot inside a blood vessel that subsequently travels through the blood stream from the site where it formed to another location in the body, generally leading to vascular occlusion at the distant site. Evidence: TAS. Frequency: Very rare (HP:0040284). (ORPHA:2494)